- Truncal ataxia (HP:0002078): Truncal ataxia is a sign of ataxia characterized by instability of the trunk. It usually occurs during sitting. Evidence: PCS. Frequency: 2/2. (PMID:26812546)
- Cerebellar hypoplasia (HP:0001321): Cerebellar hypoplasia is a descriptive term implying a cerebellum with a reduced volume, but a normal shape and is stable over time. Evidence: PCS. Frequency: 1/1. (PMID:26812546)
- Delayed ability to walk (HP:0031936): A failure to achieve the ability to walk at an appropriate developmental stage. Most children learn to walk in a series of stages, and learn to walk short distances independently between 12 and 15 months. Evidence: PCS. Frequency: 2/2. (PMID:26812546)
- Dysmetria (HP:0001310): A type of ataxia characterized by the inability to carry out movements with the correct range and motion across the plane of more than one joint related to incorrect estimation of the distances required for targeted movements. Evidence: PCS. Frequency: 2/2. (PMID:26812546)
- Babinski sign (HP:0003487): Upturning of the big toe (and sometimes fanning of the other toes) in response to stimulation of the sole of the foot. If the Babinski sign is present it can indicate damage to the corticospinal tract. Evidence: PCS. Frequency: 2/2. (PMID:26812546)
- Dysarthria (HP:0001260): Dysarthric speech is a general description referring to a neurological speech disorder characterized by poor articulation. Depending on the involved neurological structures, dysarthria may be further classified as spastic, flaccid, ataxic, hyperkinetic and hypokinetic, or mixed. Evidence: PCS. Frequency: 2/2. (PMID:26812546)
- Global developmental delay (HP:0001263): A delay in the achievement of motor or mental milestones in the domains of development of a child, including motor skills, speech and language, cognitive skills, and social and emotional skills. This term should only be used to describe children younger than five years of age. Evidence: PCS. Frequency: 2/2. (PMID:26812546)
- Nonprogressive (HP:0003680): Applies to a disease manifestation that does not increase in scope or severity over the course of time, i.e., that does not worsen with age. Evidence: PCS. (PMID:26812546)
- Ataxia (HP:0001251): Ataxia refers to impaired coordination of voluntary muscle movement. Cerebellar ataxia refers to ataxia due to dysfunction of the cerebellum. This causes a variety of elementary neurological deficits including asynergy (lack of coordination between muscles, limbs and joints), dysmetria (lack of ability to judge distances that can lead to under- or overshoot in grasping movements), and dysdiadochokinesia (inability to perform rapid movements requiring antagonizing muscle groups to be switched on and off repeatedly). Evidence: TAS. Frequency: 2/2. (OMIM:617584)
- Infantile onset (HP:0003593): Onset of signs or symptoms of disease between 28 days to one year of life. Evidence: PCS. Frequency: 2/2. (PMID:26812546)
- Autosomal recessive inheritance (HP:0000007): A mode of inheritance that is observed for traits related to a gene encoded on one of the autosomes (i.e., the human chromosomes 1-22) in which a trait manifests in individuals with two pathogenic alleles, either homozygotes (two copies of the same mutant allele) or compound heterozygotes (whereby each copy of a gene has a distinct mutant allele). Evidence: PCS. (PMID:26812546)
- Horizontal nystagmus (HP:0000666): Nystagmus consisting of horizontal to-and-fro eye movements. Evidence: PCS. Frequency: 2/2. (PMID:26812546)
- Brisk reflexes (HP:0001348): Tendon reflexes that are noticeably more active than usual (conventionally denoted 3+ on clinical examination). Brisk reflexes may or may not indicate a neurological lesion. They are distinguished from hyperreflexia by the fact that hyerreflexia is characterized by hyperactive repeating (clonic) reflexes, which are considered to be always abnormal. Evidence: PCS. Frequency: 2/2. (PMID:26812546)
These phenotypes are associated with the disease spinocerebellar ataxia, autosomal recessive 25 (OMIM:617584).